Phenotypes associated with the disease parotid salivary glands, polycystic dysgenetic disease of (OMIM:600343):
- Enlargement of parotid gland (HP:0011801): Increased size of the parotid gland. Evidence: TAS. (OMIM:600343)
- Autosomal dominant inheritance (HP:0000006): A mode of inheritance that is observed for traits related to a gene encoded on one of the autosomes (i.e., the human chromosomes 1-22) in which a trait manifests in heterozygotes. In the context of medical genetics, an autosomal dominant disorder is caused when a single copy of the mutant allele is present. Males and females are affected equally, and can both transmit the disorder with a risk of 50% for each child of inheriting the mutant allele. Evidence: TAS. (OMIM:600343)